- Delayed speech and language development (HP:0000750): A degree of language development that is significantly below the norm for a child of a specified age. Evidence: TAS. Frequency: Very frequent (HP:0040281). (ORPHA:369891)
- Global developmental delay (HP:0001263): A delay in the achievement of motor or mental milestones in the domains of development of a child, including motor skills, speech and language, cognitive skills, and social and emotional skills. This term should only be used to describe children younger than five years of age. Evidence: TAS. Frequency: Very frequent (HP:0040281). (ORPHA:369891)
- Motor delay (HP:0001270): A type of Developmental delay characterized by a delay in acquiring motor skills. Evidence: TAS. Frequency: Very frequent (HP:0040281). (ORPHA:369891)
- Wide mouth (HP:0000154): Distance between the oral commissures more than 2 SD above the mean. Alternatively, an apparently increased width of the oral aperture (subjective). Evidence: TAS. Frequency: Frequent (HP:0040282). (ORPHA:369891)
- Macroglossia (HP:0000158): Increased length and width of the tongue. Evidence: TAS. Frequency: Frequent (HP:0040282). (ORPHA:369891)
- Open mouth (HP:0000194): A facial appearance characterized by a permanently or nearly permanently opened mouth. Evidence: TAS. Frequency: Frequent (HP:0040282). (ORPHA:369891)
- Low-set ears (HP:0000369): Upper insertion of the ear to the scalp below an imaginary horizontal line drawn between the inner canthi of the eye and extending posteriorly to the ear. Evidence: TAS. Frequency: Frequent (HP:0040282). (ORPHA:369891)
- Bulbous nose (HP:0000414): Increased volume and globular shape of the anteroinferior aspect of the nose. Evidence: TAS. Frequency: Frequent (HP:0040282). (ORPHA:369891)
- Wide nasal bridge (HP:0000431): Increased breadth of the nasal bridge (and with it, the nasal root). Evidence: TAS. Frequency: Frequent (HP:0040282). (ORPHA:369891)
- Upslanted palpebral fissure (HP:0000582): The palpebral fissure inclination is more than two standard deviations above the mean for age (objective); or, the inclination of the palpebral fissure is greater than typical for age. Evidence: TAS. Frequency: Frequent (HP:0040282). (ORPHA:369891)
- Atypical behavior (HP:0000708): Atypical behavior is an abnormality in a person's actions that can be controlled or modulated by the will of the individual. While abnormal behaviors can be difficult to control, they are distinct from other abnormal actions that cannot be affected by the individual's will. Evidence: TAS. Frequency: Frequent (HP:0040282). (ORPHA:369891)
- Autistic behavior (HP:0000729): Persistent deficits in social interaction and communication and interaction as well as a markedly restricted repertoire of activity and interest as well as repetitive patterns of behavior. Evidence: TAS. Frequency: Frequent (HP:0040282). (ORPHA:369891)
- Hypotonia (HP:0001252): Hypotonia is an abnormally low muscle tone (the amount of tension or resistance to movement in a muscle). Even when relaxed, muscles have a continuous and passive partial contraction which provides some resistance to passive stretching. Hypotonia thus manifests as diminished resistance to passive stretching. Hypotonia is not the same as muscle weakness, although the two conditions can co-exist. Evidence: TAS. Frequency: Frequent (HP:0040282). (ORPHA:369891)
- Specific learning disability (HP:0001328): Impairment of certain skills such as reading or writing, coordination, self-control, or attention that interfere with the ability to learn. The impairment is not related to a global deficiency of intelligence. Evidence: TAS. Frequency: Frequent (HP:0040282). (ORPHA:369891)
- Moderate intellectual disability (HP:0002342): Moderate intellectual disability (ID) is defined as a type of ID characterized by moderately sub-average adaptive functioning and intellectual functioning, with an intelligence quotient (IQ) the range of 35-49. Evidence: TAS. Frequency: Frequent (HP:0040282). (ORPHA:369891)
- Poor speech (HP:0002465). Evidence: TAS. Frequency: Frequent (HP:0040282). (ORPHA:369891)
- Cryptorchidism (HP:0000028): Testis in inguinal canal. That is, absence of one or both testes from the scrotum owing to failure of the testis or testes to descend through the inguinal canal to the scrotum. Evidence: TAS. Frequency: Occasional (HP:0040283). (ORPHA:369891)
- High palate (HP:0000218): Height of the palate more than 2 SD above the mean (objective) or palatal height at the level of the first permanent molar more than twice the height of the teeth (subjective). Evidence: TAS. Frequency: Occasional (HP:0040283). (ORPHA:369891)
- Brachycephaly (HP:0000248): An abnormality of skull shape characterized by a decreased anterior-posterior diameter. That is, a cephalic index greater than 81%. Alternatively, an apparently shortened anteroposterior dimension (length) of the head compared to width. Evidence: TAS. Frequency: Occasional (HP:0040283). (ORPHA:369891)
- Epicanthus (HP:0000286): A fold of skin starting above the medial aspect of the upper eyelid and arching downward to cover, pass in front of and lateral to the medial canthus. Evidence: TAS. Frequency: Occasional (HP:0040283). (ORPHA:369891)
- Low anterior hairline (HP:0000294): Distance between the hairline (trichion) and the glabella (the most prominent point on the frontal bone above the root of the nose), in the midline, more than two SD below the mean. Alternatively, an apparently decreased distance between the hairline and the glabella. Evidence: TAS. Frequency: Occasional (HP:0040283). (ORPHA:369891)
- Mandibular prognathia (HP:0000303): Abnormal prominence of the chin related to increased length of the mandible. Evidence: TAS. Frequency: Occasional (HP:0040283). (ORPHA:369891)
- Round face (HP:0000311): The facial appearance is more circular than usual as viewed from the front. Evidence: TAS. Frequency: Occasional (HP:0040283). (ORPHA:369891)
- Hypertelorism (HP:0000316): Interpupillary distance more than 2 SD above the mean (alternatively, the appearance of an increased interpupillary distance or widely spaced eyes). Evidence: TAS. Frequency: Occasional (HP:0040283). (ORPHA:369891)
- Triangular face (HP:0000325): Facial contour, as viewed from the front, triangular in shape, with breadth at the temples and tapering to a narrow chin. Evidence: TAS. Frequency: Occasional (HP:0040283). (ORPHA:369891)
- Broad forehead (HP:0000337): Width of the forehead or distance between the frontotemporales is more than two standard deviations above the mean (objective); or apparently increased distance between the two sides of the forehead. Evidence: TAS. Frequency: Occasional (HP:0040283). (ORPHA:369891)
- Narrow forehead (HP:0000341): Width of the forehead or distance between the frontotemporales is more than two standard deviations below the mean (objective); or apparently narrow intertemporal region (subjective). Evidence: TAS. Frequency: Occasional (HP:0040283). (ORPHA:369891)
- Hearing impairment (HP:0000365): A decreased magnitude of the sensory perception of sound. Evidence: TAS. Frequency: Occasional (HP:0040283). (ORPHA:369891)
- Preauricular skin tag (HP:0000384): A rudimentary tag of skin often containing ear tissue including a core of cartilage and located just anterior to the auricle (outer part of the ear). Evidence: TAS. Frequency: Occasional (HP:0040283). (ORPHA:369891)
- Macrotia (HP:0000400): Median longitudinal ear length greater than two standard deviations above the mean and median ear width greater than two standard deviations above the mean (objective); or, apparent increase in length and width of the pinna (subjective). Evidence: TAS. Frequency: Occasional (HP:0040283). (ORPHA:369891)
- Short neck (HP:0000470): Diminished length of the neck. Evidence: TAS. Frequency: Occasional (HP:0040283). (ORPHA:369891)
- Ptosis (HP:0000508): The upper eyelid margin is positioned 3 mm or more lower than usual and covers the superior portion of the iris (objective); or, the upper lid margin obscures at least part of the pupil (subjective). Evidence: TAS. Frequency: Occasional (HP:0040283). (ORPHA:369891)
- Hypermetropia (HP:0000540): An abnormality of refraction characterized by the ability to see objects in the distance clearly, while objects nearby appear blurry. Evidence: TAS. Frequency: Occasional (HP:0040283). (ORPHA:369891)
- Myopia (HP:0000545): An abnormality of refraction characterized by the ability to see objects nearby clearly, while objects in the distance appear blurry. Evidence: TAS. Frequency: Occasional (HP:0040283). (ORPHA:369891)
- Widely spaced teeth (HP:0000687): Increased spaces (diastemata) between most of the teeth in the same dental arch. Evidence: TAS. Frequency: Occasional (HP:0040283). (ORPHA:369891)
- Restlessness (HP:0000711): A state of unease is characterized by diffuse motor activity or motion, which is subject to limited control, nonproductive, or disorganized behavior. Evidence: TAS. Frequency: Occasional (HP:0040283). (ORPHA:369891)
- Agitation (HP:0000713): A state of excessive motor activity that is associated with mental distress or a feeling of substantial unease or inner tension. Distinguished from restlessness by the increased level of emotional distress and negative intensity of the experience. Agitation has a significant level of physical activity that is typically threatening to the self or others. Evidence: TAS. Frequency: Occasional (HP:0040283). (ORPHA:369891)
- Autism (HP:0000717): Autism is a neurodevelopmental disorder characterized by impaired social interaction and communication, and by restricted and repetitive behavior. Autism begins in childhood. It is marked by the presence of markedly abnormal or impaired development in social interaction and communication and a markedly restricted repertoire of activity and interest. Manifestations of the disorder vary greatly depending on the developmental level and chronological age of the individual (DSM-IV). Evidence: TAS. Frequency: Occasional (HP:0040283). (ORPHA:369891)
- Aggressive behavior (HP:0000718): Behavior or an act aimed at harming a person, animal, or physical property (e.g., acts of physical violence; shouting, swearing, and using harsh language; slashing someone's tires). Evidence: TAS. Frequency: Occasional (HP:0040283). (ORPHA:369891)
- Hyperactivity (HP:0000752): Hyperactivity is a condition characterized by constant and unusually high levels of activity, even in situations where it is deemed inappropriate. Evidence: TAS. Frequency: Occasional (HP:0040283). (ORPHA:369891)
- Abnormality of the hand (HP:0001155): An abnormality affecting one or both hands. Evidence: TAS. Frequency: Occasional (HP:0040283). (ORPHA:369891)
- Syndactyly (HP:0001159): Webbing or fusion of the fingers or toes, involving soft parts only or including bone structure. Bony fusions are referred to as "bony" syndactyly if the fusion occurs in a radio-ulnar axis. Fusions of bones of the fingers or toes in a proximo-distal axis are referred to as "symphalangism". Evidence: TAS. Frequency: Occasional (HP:0040283). (ORPHA:369891)
- Ataxia (HP:0001251): Ataxia refers to impaired coordination of voluntary muscle movement. Cerebellar ataxia refers to ataxia due to dysfunction of the cerebellum. This causes a variety of elementary neurological deficits including asynergy (lack of coordination between muscles, limbs and joints), dysmetria (lack of ability to judge distances that can lead to under- or overshoot in grasping movements), and dysdiadochokinesia (inability to perform rapid movements requiring antagonizing muscle groups to be switched on and off repeatedly). Evidence: TAS. Frequency: Occasional (HP:0040283). (ORPHA:369891)
- Plagiocephaly (HP:0001357): Asymmetric head shape, which is usually a combination of unilateral occipital flattening with ipsilateral frontal prominence, leading to rhomboid cranial shape. Evidence: TAS. Frequency: Occasional (HP:0040283). (ORPHA:369891)
- Umbilical hernia (HP:0001537): Protrusion of abdominal contents through a defect in the abdominal wall musculature around the umbilicus. Skin and subcutaneous tissue overlie the defect. Evidence: TAS. Frequency: Occasional (HP:0040283). (ORPHA:369891)
- Abnormal heart morphology (HP:0001627): Any structural anomaly of the heart. Evidence: TAS. Frequency: Occasional (HP:0040283). (ORPHA:369891)
- Ventricular septal defect (HP:0001629): A hole between the two bottom chambers (ventricles) of the heart. The defect is centered around the most superior aspect of the ventricular septum. Evidence: TAS. Frequency: Occasional (HP:0040283). (ORPHA:369891)
- Patent foramen ovale (HP:0001655): Failure of the foramen ovale to seal postnatally, leaving a potential conduit between the left and right cardiac atria. Evidence: TAS. Frequency: Occasional (HP:0040283). (ORPHA:369891)
- Abnormal foot morphology (HP:0001760): An abnormality of the skeleton of foot. Evidence: TAS. Frequency: Occasional (HP:0040283). (ORPHA:369891)
- Frontal upsweep of hair (HP:0002236): Upward and/or sideward growth of anterior hair. Evidence: TAS. Frequency: Occasional (HP:0040283). (ORPHA:369891)
- Incoordination (HP:0002311): A deficit in coordination of muscle movements. Coordination is defined as the orchestrated movement of multiple body parts as required to accomplish intended actions, like walking. Evidence: TAS. Frequency: Occasional (HP:0040283). (ORPHA:369891)
- Spastic paraparesis (HP:0002313): Partial loss of the ability to move the lower limbs accompanied by spasticity of the lower limbs. Evidence: TAS. Frequency: Occasional (HP:0040283). (ORPHA:369891)
- EEG abnormality (HP:0002353): Abnormality observed by electroencephalogram (EEG), which is used to record of the brain's spontaneous electrical activity from multiple electrodes placed on the scalp. Evidence: TAS. Frequency: Occasional (HP:0040283). (ORPHA:369891)
- Downturned corners of mouth (HP:0002714): A morphological abnormality of the mouth in which the angle of the mouth is downturned. The oral commissures are positioned inferior to the midline labial fissure. Evidence: TAS. Frequency: Occasional (HP:0040283). (ORPHA:369891)
- Short nose (HP:0003196): Distance from nasion to subnasale more than two standard deviations below the mean, or alternatively, an apparently decreased length from the nasal root to the nasal tip. Evidence: TAS. Frequency: Occasional (HP:0040283). (ORPHA:369891)
- Short stature (HP:0004322): A height below that which is expected according to age and gender norms. Although there is no universally accepted definition of short stature, many refer to "short stature" as height more than 2 standard deviations below the mean for age and gender (or below the 3rd percentile for age and gender dependent norms). Evidence: TAS. Frequency: Occasional (HP:0040283). (ORPHA:369891)
- Depressed nasal bridge (HP:0005280): Posterior positioning of the nasal root in relation to the overall facial profile for age. Evidence: TAS. Frequency: Occasional (HP:0040283). (ORPHA:369891)
- Arthrogryposis-like hand anomaly (HP:0005612). Evidence: TAS. Frequency: Occasional (HP:0040283). (ORPHA:369891)
- Bilateral microphthalmos (HP:0007633): A developmental anomaly characterized by abnormal smallness of both eyes. Evidence: TAS. Frequency: Occasional (HP:0040283). (ORPHA:369891)
- Ocular anterior segment dysgenesis (HP:0007700): Abnormal development (dysgenesis) of the anterior segment of the eye globe. These structures are mainly of mesenchymal origin. Evidence: TAS. Frequency: Occasional (HP:0040283). (ORPHA:369891)
- Multifocal epileptiform discharges (HP:0010841): An abnormality in cerebral electrical activity recorded along the scalp by electroencephalography (EEG) and being identified at multiple locations (foci). Evidence: TAS. Frequency: Occasional (HP:0040283). (ORPHA:369891)
- Horizontal eyebrow (HP:0011228): An eyebrow that extends straight across the brow, without curve. Evidence: TAS. Frequency: Occasional (HP:0040283). (ORPHA:369891)
- Midface retrusion (HP:0011800): Posterior positions and/or vertical shortening of the infraorbital and perialar regions, or increased concavity of the face and/or reduced nasolabial angle. Evidence: TAS. Frequency: Occasional (HP:0040283). (ORPHA:369891)
- Camptodactyly (HP:0012385): The distal interphalangeal joint and/or the proximal interphalangeal joint of the fingers or toes cannot be extended to 180 degrees by either active or passive extension. Evidence: TAS. Frequency: Occasional (HP:0040283). (ORPHA:369891)
- Clinodactyly (HP:0030084): An angulation of a digit at an interphalangeal joint in the plane of the palm (finger) or sole (toe). Evidence: TAS. Frequency: Occasional (HP:0040283). (ORPHA:369891)
- Overfriendliness (HP:0100025): A form of hypersociability that presents as mostly inappropriate friendliness towards others. Evidence: TAS. Frequency: Occasional (HP:0040283). (ORPHA:369891)
These phenotypes are associated with the disease Developmental delay-facial dysmorphism syndrome due to MED13L deficiency (ORPHA:369891).